Phenotypes associated with the disease autosomal recessive nonsyndromic hearing loss 62 (OMIM:610143):
- Autosomal recessive inheritance (HP:0000007): A mode of inheritance that is observed for traits related to a gene encoded on one of the autosomes (i.e., the human chromosomes 1-22) in which a trait manifests in individuals with two pathogenic alleles, either homozygotes (two copies of the same mutant allele) or compound heterozygotes (whereby each copy of a gene has a distinct mutant allele). Evidence: PCS. (PMID:16650082)
- Prelingual sensorineural hearing impairment (HP:0000399): A form of sensorineural deafness with either congenital onset or infantile onset, i.e., before the acquisition of speech. Evidence: PCS. (PMID:16650082)